- Inguinal hernia (HP:0000023): Protrusion of the contents of the abdominal cavity through the inguinal canal. Evidence: TAS. Frequency: Occasional (HP:0040283). (ORPHA:2645)
- Cryptorchidism (HP:0000028): Testis in inguinal canal. That is, absence of one or both testes from the scrotum owing to failure of the testis or testes to descend through the inguinal canal to the scrotum. Evidence: TAS. Frequency: Occasional (HP:0040283). (ORPHA:2645)
- Hypertelorism (HP:0000316): Interpupillary distance more than 2 SD above the mean (alternatively, the appearance of an increased interpupillary distance or widely spaced eyes). Evidence: TAS. Frequency: Very frequent (HP:0040281). (ORPHA:2645)
- Micrognathia (HP:0000347): Developmental hypoplasia of the mandible. Evidence: TAS. Frequency: Frequent (HP:0040282). (ORPHA:2645)
- Protruding ear (HP:0000411): Angle formed by the plane of the ear and the mastoid bone greater than the 97th centile for age (objective); or, outer edge of the helix more than 2 cm from the mastoid at the point of maximum distance (objective). Evidence: TAS. Frequency: Frequent (HP:0040282). (ORPHA:2645)
- Choanal atresia (HP:0000453): Absence or abnormal closure of the choana (the posterior nasal aperture). Most embryologists believe that posterior choanal atresia results from a failure of rupture between the 35th and 38th day of fetal life of the partition which separates the bucconasal or buccopharyngeal membranes. The resultant choanal atresia may be unilateral or bilateral, bony or membranous, complete or incomplete. In over 90 per cent of cases the obstruction is bony, while in the remainder it is membranous. The bony type of atresia is commonly located 1-2 mm. anterior to the posterior edge of the hard palate, and the osseous septum varies in thickness from 1 to 10 mm. In the membranous form of choanal atresia the obstruction usually occurs further posteriorly. In approximately one third of cases the atresia is bilateral. Evidence: TAS. Frequency: Occasional (HP:0040283). (ORPHA:2645)
- Anteverted nares (HP:0000463): Anteriorly-facing nostrils viewed with the head in the Frankfurt horizontal and the eyes of the observer level with the eyes of the subject. This gives the appearance of an upturned nose (upturned nasal tip). Evidence: TAS. Frequency: Frequent (HP:0040282). (ORPHA:2645)
- Abnormal clavicle morphology (HP:0000889): Any abnormality of the clavicles (collar bones). Evidence: TAS. Frequency: Frequent (HP:0040282). (ORPHA:2645)
- Brachydactyly (HP:0001156): Digits that appear disproportionately short compared to the hand/foot. The word brachydactyly is used here to describe a series distinct patterns of shortened digits (brachydactyly types A-E). This is the sense used here. Evidence: TAS. Frequency: Occasional (HP:0040283). (ORPHA:2645)
- Intellectual disability (HP:0001249): The term intellectual disability or intellectual developmental disorder is used to describe significantly sub-average intellectual and adaptive functioning based on clinical assessment and as measured by individually administered, appropriately normed, standardized and validated tests of intellectual functioning and adaptive behavior, with onset during the developmental period from infancy through adolescence. Evidence: TAS. Frequency: Occasional (HP:0040283). (ORPHA:2645)
- Craniosynostosis (HP:0001363): Craniosynostosis refers to the premature closure of the cranial sutures. Primary craniosynostosis refers to the closure of one or more sutures due to abnormalities in skull development, and secondary craniosynostosis results from failure of brain growth. Evidence: TAS. Frequency: Very frequent (HP:0040281). (ORPHA:2645)
- Failure to thrive in infancy (HP:0001531). Evidence: TAS. Frequency: Frequent (HP:0040282). (ORPHA:2645)
- Scoliosis (HP:0002650): The presence of an abnormal lateral curvature of the spine. Evidence: TAS. Frequency: Occasional (HP:0040283). (ORPHA:2645)
- Delayed skeletal maturation (HP:0002750): A decreased rate of skeletal maturation. Delayed skeletal maturation can be diagnosed on the basis of an estimation of the bone age from radiographs of specific bones in the human body. Evidence: TAS. Frequency: Frequent (HP:0040282). (ORPHA:2645)
- Abnormal vertebral body morphology (HP:0003312): Abnormal form of vertebral body, which is the central cylindrical portion of the vertebra that together with other structures such as the vertebral arch, pedicles, laminae, spinous process, transverse processes, and articular facets makes up a vertebra. Evidence: TAS. Frequency: Very frequent (HP:0040281). (ORPHA:2645)
- Severe short stature (HP:0003510): A severe degree of short stature, more than -4 SD from the mean corrected for age and sex. Evidence: TAS. Frequency: Very frequent (HP:0040281). (ORPHA:2645)
- Multiple unerupted teeth (HP:0006283): The presence of multiple embedded tooth germs which have failed to erupt. Evidence: TAS. Frequency: Very frequent (HP:0040281). (ORPHA:2645)
- Rhizomelia (HP:0008905): Disproportionate shortening of the proximal segment of limbs (i.e. the femur and humerus). Evidence: TAS. Frequency: Frequent (HP:0040282). (ORPHA:2645)
- Tooth agenesis (HP:0009804): The absence of one or more teeth from the normal series by a failure to develop. Evidence: TAS. Frequency: Very frequent (HP:0040281). (ORPHA:2645)
- Abnormal bone ossification (HP:0011849): Any anomaly in the formation of bone or of a bony substance, or the conversion of fibrous tissue or of cartilage into bone or a bony substance. Evidence: TAS. Frequency: Occasional (HP:0040283). (ORPHA:2645)
These phenotypes are associated with the disease Osteoglosphonic dysplasia (ORPHA:2645).